- Iron deficiency anemia (HP:0001891). Evidence: TAS. Frequency: Very frequent (HP:0040281). (ORPHA:209981)
- Hypochromic microcytic anemia (HP:0004840): A type of anemia characterized by an abnormally low concentration of hemoglobin in the erythrocytes and lower than normal size of the erythrocytes. Evidence: TAS. Frequency: Very frequent (HP:0040281). (ORPHA:209981)
- Decreased mean corpuscular volume (HP:0025066): A reduction from normal of the mean corpuscular volume, or mean cell volume (MCV) of red blood cells (usually defined as an MCV below 80 femtoliters). Evidence: TAS. Frequency: Very frequent (HP:0040281). (ORPHA:209981)
- Decreased transferrin saturation (HP:0012464): A below normal level of saturation of serum transferrin with iron. Evidence: TAS. Frequency: Frequent (HP:0040282). (ORPHA:209981)
- Elevated circulating hepcidin concentration (HP:0031877): Concentration of hepcidin in the blood circulation above the upper limit of normal. Evidence: TAS. Frequency: Frequent (HP:0040282). (ORPHA:209981)
- Decreased circulating iron concentration (HP:0040303): The concentration of iron cation in the blood circulation is below the lower limit of normal. Evidence: TAS. Frequency: Frequent (HP:0040282). (ORPHA:209981)
- Anemic pallor (HP:0001017): A type of pallor that is secondary to the presence of anemia. Evidence: TAS. Frequency: Occasional (HP:0040283). (ORPHA:209981)
- Angular cheilitis (HP:0030318): A type of inflammation of the lips involving one or both of the corners of the mouth. Evidence: TAS. Frequency: Occasional (HP:0040283). (ORPHA:209981)
- Alopecia (HP:0001596): A noncongenital process of hair loss, which may progress to partial or complete baldness. Evidence: TAS. Frequency: Very rare (HP:0040284). (ORPHA:209981)
- Concave nail (HP:0001598): The natural longitudinal (posterodistal) convex arch is not present or is inverted. Evidence: TAS. Frequency: Very rare (HP:0040284). (ORPHA:209981)
These phenotypes are associated with the disease IRIDA syndrome (ORPHA:209981).